- Abnormality of the skeletal system (HP:0000924): An abnormality of the skeletal system. Evidence: IEA. (OMIM:189000)
- Autosomal dominant inheritance (HP:0000006): A mode of inheritance that is observed for traits related to a gene encoded on one of the autosomes (i.e., the human chromosomes 1-22) in which a trait manifests in heterozygotes. In the context of medical genetics, an autosomal dominant disorder is caused when a single copy of the mutant allele is present. Males and females are affected equally, and can both transmit the disorder with a risk of 50% for each child of inheriting the mutant allele. Evidence: TAS. (OMIM:189000)
These phenotypes are associated with the disease toe, fifth, number of phalanges 1N (OMIM:189000).